Phenotypes associated with the disease Non-24-hour sleep-wake syndrome (ORPHA:73267):
- Blindness (HP:0000618): Blindness is the condition of lacking visual perception defined as a profound reduction in visual perception. On the 6m visual acuity scale, blindness is defined as less than 3/60. On the 20ft visual acuity scale, blindness is defined as less than 20/400. On the decimal visual acuity scale, blindness is defined as less than 0.05. Blindness is typically characterized by a visual field of no greater than 10 degrees in radius around central fixation. Evidence: TAS. Frequency: Frequent (HP:0040282). (ORPHA:73267)
- Depression (HP:0000716): Frequently experiencing feelings of being down, miserable, and/or hopeless; struggling to recover from these moods; having a pessimistic outlook on the future; feeling a pervasive sense of shame; having a low self-worth; experiencing thoughts of suicide and engaging in suicidal behavior. Evidence: TAS. Frequency: Frequent (HP:0040282). (ORPHA:73267)
- Excessive daytime somnolence (HP:0001262): A state of abnormally strong desire for sleep during the daytime. Evidence: TAS. Frequency: Frequent (HP:0040282). (ORPHA:73267)
- Abnormal pineal melatonin secretion (HP:0012689): An anomaly in the amount or timing of melatonin secretion by the pineal gland. Note that melatonin is also synthesized by multiple tissues outside of the pineal gland. Evidence: TAS. Frequency: Frequent (HP:0040282). (ORPHA:73267)
- Asthenia (HP:0025406): A state characterized by a feeling of weakness and loss of strength leading to a generalized weakness of the body. Evidence: TAS. Frequency: Frequent (HP:0040282). (ORPHA:73267)